- Uterine leiomyoma (HP:0000131): The presence of a leiomyoma of the uterus. Evidence: PCS. (PMID:21868628)
- Typified by somatic mosaicism (HP:0001442): Description of conditions in which affected individuals typically display somatic mosaicism, i.e., genetically distinct populations of somatic cells in a given organism caused by DNA mutations, epigenetic alterations of DNA, chromosomal abnormalities or the spontaneous reversion of inherited mutations. In many conditions typified by somatic mosaicism, constitutive mutation is lethal and cases are exclusively or predominantly mosaic. Evidence: PCS. (PMID:21868628)
- Adult onset (HP:0003581): Onset of disease manifestations in adulthood, defined here as at the age of 16 years or later. Evidence: PCS. (PMID:21868628)
These phenotypes are associated with the disease uterine corpus leiomyoma (OMIM:150699).